Phenotypes associated with the disease pulmonary bullae causing pneumothorax (OMIM:265200):
- Autosomal recessive inheritance (HP:0000007): A mode of inheritance that is observed for traits related to a gene encoded on one of the autosomes (i.e., the human chromosomes 1-22) in which a trait manifests in individuals with two pathogenic alleles, either homozygotes (two copies of the same mutant allele) or compound heterozygotes (whereby each copy of a gene has a distinct mutant allele). Evidence: IEA. (OMIM:265200)
- Repeated pneumothoraces (HP:0006522). Evidence: IEA. (OMIM:265200)